Phenotypes associated with the disease pancreatic cancer, susceptibility to, 5 (OMIM:618680, an entry in Online Mendelian Inheritance in Man):
- Melanoma (HP:0002861, a Human Phenotype Ontology term): The presence of a melanoma, a malignant cancer originating from pigment producing melanocytes. Melanoma can originate from the skin or the pigmented layers of the eye (the uvea). Evidence: PCS. Onset: Middle age onset (HP:0003596, a Human Phenotype Ontology term). (PMID:31406347)
- Pancreatic adenocarcinoma (HP:0006725, a Human Phenotype Ontology term): The presence of an adenocarcinoma of the pancreas. Evidence: IEA. Onset: Middle age onset (HP:0003596, a Human Phenotype Ontology term). (PMID:31406347)
- Autosomal dominant inheritance (HP:0000006, a Human Phenotype Ontology term): A mode of inheritance that is observed for traits related to a gene encoded on one of the autosomes (i.e., the human chromosomes 1-22) in which a trait manifests in heterozygotes. In the context of medical genetics, an autosomal dominant disorder is caused when a single copy of the mutant allele is present. Males and females are affected equally, and can both transmit the disorder with a risk of 50% for each child of inheriting the mutant allele. Evidence: PCS. (PMID:31406347)